- Otosclerosis (HP:0000362): In otosclerosis, a callus of bone accumulates on the stapes creating a partial fixation. This limits the movement of the stapes bone, which results in hearing loss. Evidence: IEA. (OMIM:612096)
- Hearing impairment (HP:0000365): A decreased magnitude of the sensory perception of sound. Evidence: IEA. (OMIM:612096)
- Autosomal dominant inheritance (HP:0000006): A mode of inheritance that is observed for traits related to a gene encoded on one of the autosomes (i.e., the human chromosomes 1-22) in which a trait manifests in heterozygotes. In the context of medical genetics, an autosomal dominant disorder is caused when a single copy of the mutant allele is present. Males and females are affected equally, and can both transmit the disorder with a risk of 50% for each child of inheriting the mutant allele. Evidence: IEA. (OMIM:612096)
These phenotypes are associated with the disease otosclerosis 8 (OMIM:612096).